Phenotypes associated with the disease hemangiomas of small intestine (OMIM:140900):
- Cavernous hemangioma (HP:0001048): The presence of a cavernous hemangioma. A hemangioma characterized by large endothelial spaces (caverns) is called a cavernous hemangioma. Evidence: TAS. (OMIM:140900)
- Autosomal dominant inheritance (HP:0000006): A mode of inheritance that is observed for traits related to a gene encoded on one of the autosomes (i.e., the human chromosomes 1-22) in which a trait manifests in heterozygotes. In the context of medical genetics, an autosomal dominant disorder is caused when a single copy of the mutant allele is present. Males and females are affected equally, and can both transmit the disorder with a risk of 50% for each child of inheriting the mutant allele. Evidence: IEA. (OMIM:140900)